Phenotypes associated with the disease Gerstmann-Straussler-Scheinker syndrome (OMIM:137440):
- Bradykinesia (HP:0002067): Bradykinesia literally means slow movement, and is used clinically to denote a slowness in the execution of movement (in contrast to hypokinesia, which is used to refer to slowness in the initiation of movement). Evidence: IEA. (OMIM:137440)
- Cerebellar atrophy (HP:0001272): Cerebellar atrophy is defined as a cerebellum with initially normal structures, in a posterior fossa with normal size, which displays enlarged fissures (interfolial spaces) in comparison to the foliae secondary to loss of tissue. Cerebellar atrophy implies irreversible loss of tissue and result from an ongoing progressive disease until a final stage is reached or a single injury, e.g. an intoxication or infectious event. Evidence: IEA. (OMIM:137440)
- Apraxia (HP:0002186): A defect in the understanding of complex motor commands and in the execution of certain learned movements, i.e., deficits in the cognitive components of learned movements. Evidence: IEA. (OMIM:137440)
- Gait ataxia (HP:0002066): A type of ataxia characterized by the impairment of the ability to coordinate the movements required for normal walking. Gait ataxia is characteirzed by a wide-based staggering gait with a tendency to fall. Evidence: IEA. (OMIM:137440)
- Rigidity (HP:0002063): Continuous involuntary sustained muscle contraction. When an affected muscle is passively stretched, the degree of resistance remains constant regardless of the rate at which the muscle is stretched. This feature helps to distinguish rigidity from muscle spasticity. Evidence: TAS. (OMIM:137440)
- Neurofibrillary tangles (HP:0002185): Pathological protein aggregates formed by hyperphosphorylation of a microtubule-associated protein known as tau, causing it to aggregate in an insoluble form. Evidence: IEA. (OMIM:137440)
- Depression (HP:0000716): Frequently experiencing feelings of being down, miserable, and/or hopeless; struggling to recover from these moods; having a pessimistic outlook on the future; feeling a pervasive sense of shame; having a low self-worth; experiencing thoughts of suicide and engaging in suicidal behavior. Evidence: TAS. (OMIM:137440)
- Lower limb muscle weakness (HP:0007340): Weakness of the muscles of the legs. Evidence: IEA. (OMIM:137440)
- Aggressive behavior (HP:0000718): Behavior or an act aimed at harming a person, animal, or physical property (e.g., acts of physical violence; shouting, swearing, and using harsh language; slashing someone's tires). Evidence: TAS. (OMIM:137440)
- Emotional lability (HP:0000712): Unstable emotional experiences and frequent mood changes; emotions that are easily aroused, intense, and/or disproportionate to events and circumstances. Evidence: TAS. (OMIM:137440)
- Weight loss (HP:0001824): Reduction of total body weight. Evidence: TAS. (OMIM:137440)
- Personality changes (HP:0000751): An abnormal shift in patterns of thinking, acting, or feeling. Evidence: TAS. (OMIM:137440)
- Hyperreflexia (HP:0001347): Hyperreflexia is the presence of hyperactive stretch reflexes of the muscles. Evidence: IEA. (OMIM:137440)
- Parkinsonism (HP:0001300): Characteristic neurologic anomaly resulting from degeneration of dopamine-generating cells in the substantia nigra, a region of the midbrain, characterized clinically by shaking, rigidity, slowness of movement and difficulty with walking and gait. Evidence: IEA. (OMIM:137440)
- Truncal ataxia (HP:0002078): Truncal ataxia is a sign of ataxia characterized by instability of the trunk. It usually occurs during sitting. Evidence: IEA. (OMIM:137440)
- Memory impairment (HP:0002354): An impairment of memory as manifested by a reduced ability to remember things such as dates and names, and increased forgetfulness. Evidence: IEA. (OMIM:137440)
- Perseverative thought (HP:0030223): The repetitive production of the same response to different commands. Evidence: TAS. (OMIM:137440)
- Dysarthria (HP:0001260): Dysarthric speech is a general description referring to a neurological speech disorder characterized by poor articulation. Depending on the involved neurological structures, dysarthria may be further classified as spastic, flaccid, ataxic, hyperkinetic and hypokinetic, or mixed. Evidence: IEA. (OMIM:137440)
- Adult onset (HP:0003581): Onset of disease manifestations in adulthood, defined here as at the age of 16 years or later. Evidence: TAS. (OMIM:137440)
- Areflexia (HP:0001284): Absence of neurologic reflexes such as the knee-jerk reaction. Evidence: IEA. (OMIM:137440)
- Limb ataxia (HP:0002070): A kind of ataxia that affects movements of the extremities. Evidence: IEA. (OMIM:137440)
- Psychosis (HP:0000709): A condition characterized by changes in personality and thought patterns, often accompanied by hallucinations and delusional beliefs, is known as psychosis. Evidence: TAS. (OMIM:137440)
- Dementia (HP:0000726): A loss of global cognitive ability of sufficient amount to interfere with normal social or occupational function. Dementia represents a loss of previously present cognitive abilities, generally in adults, and can affect memory, thinking, language, judgment, and behavior. Evidence: TAS. Onset: Late onset (HP:0003584). (OMIM:137440)
- Impaired smooth pursuit (HP:0007772): An impairment of the ability to track objects with the ocular smooth pursuit system, a class of rather slow eye movements that minimizes retinal target motion. Evidence: IEA. (OMIM:137440)
- Spasticity (HP:0001257): A motor disorder characterized by a velocity-dependent increase in tonic stretch reflexes with increased muscle tone, exaggerated (hyperexcitable) tendon reflexes. Evidence: TAS. (OMIM:137440)
- Autosomal dominant inheritance (HP:0000006): A mode of inheritance that is observed for traits related to a gene encoded on one of the autosomes (i.e., the human chromosomes 1-22) in which a trait manifests in heterozygotes. In the context of medical genetics, an autosomal dominant disorder is caused when a single copy of the mutant allele is present. Males and females are affected equally, and can both transmit the disorder with a risk of 50% for each child of inheriting the mutant allele. Evidence: TAS. (OMIM:137440)
- Tremor (HP:0001337): An unintentional, oscillating to-and-fro muscle movement about a joint axis. Evidence: IEA. (OMIM:137440)
- Myoclonus (HP:0001336): Very brief, involuntary random muscular contractions occurring at rest, in response to sensory stimuli, or accompanying voluntary movements. Evidence: IEA. (OMIM:137440)
- Rapidly progressive (HP:0003678): Applies to a disease manifestation that quickly increases in scope or severity over the course of time. Evidence: TAS. (OMIM:137440)